- Long palpebral fissure (HP:0000637): Distance between medial and lateral canthi is more than two standard deviations above the mean for age (objective); or, apparently increased length of the palpebral fissures. Evidence: TAS. Frequency: Very frequent (HP:0040281). (ORPHA:1527)
- Craniosynostosis (HP:0001363): Craniosynostosis refers to the premature closure of the cranial sutures. Primary craniosynostosis refers to the closure of one or more sutures due to abnormalities in skull development, and secondary craniosynostosis results from failure of brain growth. Evidence: TAS. Frequency: Very frequent (HP:0040281). (ORPHA:1527)
- Finger syndactyly (HP:0006101): Webbing or fusion of the fingers, involving soft parts only or including bone structure. Bony fusions are referred to as "bony" Syndactyly if the fusion occurs in a radio-ulnar axis. Fusions of bones of the fingers in a proximo-distal axis are referred to as "Symphalangism". Evidence: TAS. Frequency: Very frequent (HP:0040281). (ORPHA:1527)
These phenotypes are associated with the disease Craniosynostosis, Philadelphia type (ORPHA:1527).